Phenotypes associated with the disease plasma fibronectin deficiency (OMIM:614101):
- Reduced circulating fibronectin level (HP:0032463): A reduction below the normal concentration of fibronectin the the blood circulation. Evidence: PCS. Frequency: 8/8. (PMID:2869211)
- Autosomal dominant inheritance (HP:0000006): A mode of inheritance that is observed for traits related to a gene encoded on one of the autosomes (i.e., the human chromosomes 1-22) in which a trait manifests in heterozygotes. In the context of medical genetics, an autosomal dominant disorder is caused when a single copy of the mutant allele is present. Males and females are affected equally, and can both transmit the disorder with a risk of 50% for each child of inheriting the mutant allele. Evidence: PCS. (PMID:2869211)